Phenotypes associated with the disease parasomnia, sleepwalking type (OMIM:613938):
- Sleep terror (HP:0030765): Autonomic arousal, screaming, sweating, crying, outbursts during sleep, usually no recollection at the individual level; typically observed by others. Evidence: TAS. (OMIM:613938)
- Autosomal dominant inheritance (HP:0000006): A mode of inheritance that is observed for traits related to a gene encoded on one of the autosomes (i.e., the human chromosomes 1-22) in which a trait manifests in heterozygotes. In the context of medical genetics, an autosomal dominant disorder is caused when a single copy of the mutant allele is present. Males and females are affected equally, and can both transmit the disorder with a risk of 50% for each child of inheriting the mutant allele. Evidence: TAS. (OMIM:613938)